Phenotypes associated with the disease Paris-Trousseau thrombocytopenia (ORPHA:851):
- Intellectual disability (HP:0001249): The term intellectual disability or intellectual developmental disorder is used to describe significantly sub-average intellectual and adaptive functioning based on clinical assessment and as measured by individually administered, appropriately normed, standardized and validated tests of intellectual functioning and adaptive behavior, with onset during the developmental period from infancy through adolescence. Evidence: TAS. Frequency: Frequent (HP:0040282). (ORPHA:851)
- Abnormality of the cardiovascular system (HP:0001626): Any abnormality of the cardiovascular system. Evidence: TAS. Frequency: Frequent (HP:0040282). (ORPHA:851)